- Resting tremor (HP:0002322): A resting tremor occurs when muscles are at rest and becomes less noticeable or disappears when the affected muscles are moved. Resting tremors are often slow and coarse. Evidence: PCS. Frequency: 4/6. (PMID:32201884)
- Middle age onset (HP:0003596): A type of adult onset with onset of symptoms at the age of 40 to 60 years. Evidence: PCS. Frequency: 5/6. (PMID:32201884)
- Depression (HP:0000716): Frequently experiencing feelings of being down, miserable, and/or hopeless; struggling to recover from these moods; having a pessimistic outlook on the future; feeling a pervasive sense of shame; having a low self-worth; experiencing thoughts of suicide and engaging in suicidal behavior. Evidence: PCS. Frequency: 2/6. (PMID:32201884)
- Young adult onset (HP:0011462): Onset of disease at the age of between 16 and 40 years. Evidence: PCS. Frequency: 1/6. (PMID:32201884)
- Rigidity (HP:0002063): Continuous involuntary sustained muscle contraction. When an affected muscle is passively stretched, the degree of resistance remains constant regardless of the rate at which the muscle is stretched. This feature helps to distinguish rigidity from muscle spasticity. Evidence: PCS. Frequency: 1/6. (PMID:32201884)
- Parkinsonism with favorable response to dopaminergic medication (HP:0002548): Parkinsonism is a clinical syndrome that is a feature of a number of different diseases, including Parkinson disease itself, other neurodegenerative diseases such as progressive supranuclear palsy, and as a side-effect of some neuroleptic medications. Some but not all individuals with Parkinsonism show responsiveness to dopaminergic medication defined as a substantial reduction of amelioration of the component signs of Parkinsonism (including mainly tremor, bradykinesia, rigidity, and postural instability) upon administration of dopaminergic medication. Evidence: PCS. Frequency: 6/6. (PMID:32201884)
- Autosomal dominant inheritance (HP:0000006): A mode of inheritance that is observed for traits related to a gene encoded on one of the autosomes (i.e., the human chromosomes 1-22) in which a trait manifests in heterozygotes. In the context of medical genetics, an autosomal dominant disorder is caused when a single copy of the mutant allele is present. Males and females are affected equally, and can both transmit the disorder with a risk of 50% for each child of inheriting the mutant allele. Evidence: PCS. (PMID:32201884)
These phenotypes are associated with the disease Parkinson disease 24, autosomal dominant, susceptibility to (OMIM:619491).